- Thrombocytopenia (HP:0001873): A reduction in the number of circulating thrombocytes. Evidence: TAS. Frequency: Very frequent (HP:0040281). (ORPHA:3439)
- Occipital encephalocele (HP:0002085): A type of encephalocele (that is, a a protrusion of part of the cranial contents including brain tissue through a congenital opening in the cranium, typically covered with skin or mucous membrane) in the occipital region of the skull. Occipital encephalocele presents as a midline swelling over the occipital bone. It is usually covered with normal full-thickness scalp. Evidence: TAS. Frequency: Very frequent (HP:0040281). (ORPHA:3439)
- Aplasia/hypoplasia involving bones of the upper limbs (HP:0006496): Absence (due to failure to form) or underdevelopment of the bones of the upper limbs. Evidence: TAS. Frequency: Very frequent (HP:0040281). (ORPHA:3439)
- Upper limb phocomelia (HP:0009813): Missing or malformed long bones of the upper limbs with the distal parts (the hands) connected to the variably shortened or even absent upper extremity, leading to a flipper-like appearance, as opposed to other forms of limb malformations were either the whole limb is missing (such as amelia), or the distal part of a limb is absent (peromelia). Evidence: TAS. Frequency: Very frequent (HP:0040281). (ORPHA:3439)
- Delayed speech and language development (HP:0000750): A degree of language development that is significantly below the norm for a child of a specified age. Evidence: TAS. Frequency: Frequent (HP:0040282). (ORPHA:3439)
- Global developmental delay (HP:0001263): A delay in the achievement of motor or mental milestones in the domains of development of a child, including motor skills, speech and language, cognitive skills, and social and emotional skills. This term should only be used to describe children younger than five years of age. Evidence: TAS. Frequency: Frequent (HP:0040282). (ORPHA:3439)
- Specific learning disability (HP:0001328): Impairment of certain skills such as reading or writing, coordination, self-control, or attention that interfere with the ability to learn. The impairment is not related to a global deficiency of intelligence. Evidence: TAS. Frequency: Frequent (HP:0040282). (ORPHA:3439)
- Aplasia/Hypoplasia of the radius (HP:0006501): A small/hypoplastic or absent/aplastic radius. Evidence: TAS. Frequency: Frequent (HP:0040282). (ORPHA:3439)
- Aplasia/Hypoplasia of the corpus callosum (HP:0007370): Absence or underdevelopment of the corpus callosum. Evidence: TAS. Frequency: Frequent (HP:0040282). (ORPHA:3439)
- Cryptorchidism (HP:0000028): Testis in inguinal canal. That is, absence of one or both testes from the scrotum owing to failure of the testis or testes to descend through the inguinal canal to the scrotum. Evidence: TAS. Frequency: Occasional (HP:0040283). (ORPHA:3439)
- Hydrocele testis (HP:0000034): Accumulation of clear fluid in the between the layers of membrane (tunica vaginalis) surrounding the testis. Evidence: TAS. Frequency: Occasional (HP:0040283). (ORPHA:3439)
- Hypogonadotropic hypogonadism (HP:0000044): Hypogonadotropic hypogonadism is characterized by reduced function of the gonads (testes in males or ovaries in females) and results from the absence of the gonadal stimulating pituitary hormones: follicle stimulating hormone (FSH) and luteinizing hormone (LH). Evidence: TAS. Frequency: Occasional (HP:0040283). (ORPHA:3439)
- Hypospadias (HP:0000047): Abnormal position of urethral meatus on the ventral penile shaft (underside) characterized by displacement of the urethral meatus from the tip of the glans penis to the ventral surface of the penis, scrotum, or perineum. Evidence: TAS. Frequency: Occasional (HP:0040283). (ORPHA:3439)
- Micropenis (HP:0000054): Abnormally small penis. At birth, the normal penis is about 3 cm (stretched length from pubic tubercle to tip of penis) with micropenis less than 2.0-2.5 cm. Evidence: TAS. Frequency: Occasional (HP:0040283). (ORPHA:3439)
- Ambiguous genitalia (HP:0000062): A genital phenotype that is not clearly assignable to a single gender. Ambiguous genitalia can be evaluated using the Prader scale: Prader 0: Normal female external genitalia. Prader 1: Female external genitalia with clitoromegaly. Prader 2: Clitoromegaly with partial labial fusion forming a funnel-shaped urogenital sinus. Prader 3: Increased phallic enlargement. Complete labioscrotal fusion forming a urogenital sinus with a single opening. Prader 4: Complete scrotal fusion with urogenital opening at the base or on the shaft of the phallus. Prader 5: Normal male external genitalia. The diagnosis of ambiguous genitalia is made for Prader 1-4. Evidence: TAS. Frequency: Occasional (HP:0040283). (ORPHA:3439)
- Abnormality of the urinary system (HP:0000079): An abnormality of the urinary system. Evidence: TAS. Frequency: Occasional (HP:0040283). (ORPHA:3439)
- Choanal atresia (HP:0000453): Absence or abnormal closure of the choana (the posterior nasal aperture). Most embryologists believe that posterior choanal atresia results from a failure of rupture between the 35th and 38th day of fetal life of the partition which separates the bucconasal or buccopharyngeal membranes. The resultant choanal atresia may be unilateral or bilateral, bony or membranous, complete or incomplete. In over 90 per cent of cases the obstruction is bony, while in the remainder it is membranous. The bony type of atresia is commonly located 1-2 mm. anterior to the posterior edge of the hard palate, and the osseous septum varies in thickness from 1 to 10 mm. In the membranous form of choanal atresia the obstruction usually occurs further posteriorly. In approximately one third of cases the atresia is bilateral. Evidence: TAS. Frequency: Occasional (HP:0040283). (ORPHA:3439)
- Tooth malposition (HP:0000692): Abnormal alignment, positioning, or spacing of the teeth, i.e., misaligned teeth. Evidence: TAS. Frequency: Occasional (HP:0040283). (ORPHA:3439)
- Seizure (HP:0001250): A seizure is an intermittent abnormality of nervous system physiology characterized by a transient occurrence of signs and/or symptoms due to abnormal excessive or synchronous neuronal activity in the brain. Evidence: TAS. Frequency: Occasional (HP:0040283). (ORPHA:3439)
- Abnormal heart morphology (HP:0001627): Any structural anomaly of the heart. Evidence: TAS. Frequency: Occasional (HP:0040283). (ORPHA:3439)
- Scoliosis (HP:0002650): The presence of an abnormal lateral curvature of the spine. Evidence: TAS. Frequency: Occasional (HP:0040283). (ORPHA:3439)
- Kyphosis (HP:0002808): Exaggerated anterior convexity of the thoracic vertebral column. Evidence: TAS. Frequency: Occasional (HP:0040283). (ORPHA:3439)
- Arachnoid cyst (HP:0100702): An extra-parenchymal and intra-arachnoidal collection of fluid with a composition similar to that of cerebrospinal fluid. Evidence: TAS. Frequency: Occasional (HP:0040283). (ORPHA:3439)
These phenotypes are associated with the disease Von Voss-Cherstvoy syndrome (ORPHA:3439).